Phenotypes associated with the disease Bardet-Biedl syndrome 10 (OMIM:615987):
- Mild intellectual disability (HP:0001256): Mild intellectual disability (ID) is defined as a type of ID characterized by mildly sub-average adaptive functioning and intellectual functioning, with an intelligence quotient (IQ) the range of 50-69. Evidence: PCS. Frequency: 1/1. (PMID:34900151)
- Seizure (HP:0001250): A seizure is an intermittent abnormality of nervous system physiology characterized by a transient occurrence of signs and/or symptoms due to abnormal excessive or synchronous neuronal activity in the brain. Evidence: PCS. Frequency: 1/1. (PMID:34900151)
- Renal insufficiency (HP:0000083): A reduction in the level of performance of the kidneys in areas of function comprising the concentration of urine, removal of wastes, the maintenance of electrolyte balance, homeostasis of blood pressure, and calcium metabolism. Evidence: TAS. (OMIM:615987)
- Global developmental delay (HP:0001263): A delay in the achievement of motor or mental milestones in the domains of development of a child, including motor skills, speech and language, cognitive skills, and social and emotional skills. This term should only be used to describe children younger than five years of age. Evidence: PCS. Frequency: 1/1. (PMID:34900151)
- Renal cyst (HP:0000107): A fluid filled sac in the kidney. Evidence: TAS. (OMIM:615987)
- Autosomal recessive inheritance (HP:0000007): A mode of inheritance that is observed for traits related to a gene encoded on one of the autosomes (i.e., the human chromosomes 1-22) in which a trait manifests in individuals with two pathogenic alleles, either homozygotes (two copies of the same mutant allele) or compound heterozygotes (whereby each copy of a gene has a distinct mutant allele). Evidence: PCS. (PMID:16582908)
- Polydactyly (HP:0010442): A congenital anomaly characterized by the presence of supernumerary fingers or toes. Evidence: PCS. Frequency: 0/1. (PMID:34900151)
- Rod-cone dystrophy (HP:0000510): An inherited retinal disease subtype in which the rod photoreceptors appear to be more severely affected than the cone photoreceptors. Typical presentation is with nyctalopia (due to rod dysfunction) followed by loss of mid-peripheral field of vision, which gradually extends and leaves many patients with a small central island of vision due to the preservation of macular cones. Evidence: PCS. Frequency: 1/1. (PMID:34900151)
- Hypogonadism (HP:0000135): A decreased functionality of the gonad. Evidence: TAS. (OMIM:615987)
- Obesity (HP:0001513): Accumulation of substantial excess body fat. Evidence: PCS. Frequency: 1/1. (PMID:34900151)
- Retinal dystrophy (HP:0000556): Retinal dystrophy is an abnormality of the retina associated with a hereditary process. Retinal dystrophies are defined by their predominantly monogenic inheritance and they are frequently associated with loss or dysfunction of photoreceptor cells as a primary or secondary event. Evidence: PCS. Frequency: 1/1. (PMID:34900151)